Phenotypes associated with the disease Posttransplant acute limbic encephalitis (ORPHA:163921):
- Seizure (HP:0001250): A seizure is an intermittent abnormality of nervous system physiology characterized by a transient occurrence of signs and/or symptoms due to abnormal excessive or synchronous neuronal activity in the brain. Evidence: TAS. Frequency: Frequent (HP:0040282). (ORPHA:163921)
- Memory impairment (HP:0002354): An impairment of memory as manifested by a reduced ability to remember things such as dates and names, and increased forgetfulness. Evidence: TAS. Frequency: Frequent (HP:0040282). (ORPHA:163921)
- Hyponatremia (HP:0002902): The concentration of sodium in the blood circulation is below the lower limit of normal. Evidence: TAS. Frequency: Frequent (HP:0040282). (ORPHA:163921)
- Increased CSF protein concentration (HP:0002922): Increased concentration of protein in the cerebrospinal fluid. Evidence: TAS. Frequency: Frequent (HP:0040282). (ORPHA:163921)
- EEG with focal epileptiform discharges (HP:0011185): EEG discharges recorded in particular areas of a localized (focal) abnormality in cerebral electrical activity recorded along the scalp by electroencephalography (EEG). Evidence: TAS. Frequency: Frequent (HP:0040282). (ORPHA:163921)
- CSF polymorphonuclear pleocytosis (HP:0012756): An increased polymorphonuclear cell count in the cerebrospinal fluid. Evidence: TAS. Frequency: Frequent (HP:0040282). (ORPHA:163921)
- Viremia (HP:0020071): The presence of virus in the blood. Evidence: TAS. Frequency: Frequent (HP:0040282). (ORPHA:163921)
- Hyperglycorrhachia (HP:0031885): Abnormally high glucose concentration in the cerebrospinal fluid. Evidence: TAS. Frequency: Frequent (HP:0040282). (ORPHA:163921)
- Sepsis (HP:0100806): Sepsis is defined as life-threatening organ dysfunction caused by a dysregulated host response to infection. Evidence: TAS. Frequency: Frequent (HP:0040282). (ORPHA:163921)
- CSF lymphocytic pleiocytosis (HP:0200149): An increased lymphocyte count in the cerebrospinal fluid. Evidence: TAS. Frequency: Frequent (HP:0040282). (ORPHA:163921)
- Atypical behavior (HP:0000708): Atypical behavior is an abnormality in a person's actions that can be controlled or modulated by the will of the individual. While abnormal behaviors can be difficult to control, they are distinct from other abnormal actions that cannot be affected by the individual's will. Evidence: TAS. Frequency: Occasional (HP:0040283). (ORPHA:163921)
- Psychosis (HP:0000709): A condition characterized by changes in personality and thought patterns, often accompanied by hallucinations and delusional beliefs, is known as psychosis. Evidence: TAS. Frequency: Occasional (HP:0040283). (ORPHA:163921)
- Depression (HP:0000716): Frequently experiencing feelings of being down, miserable, and/or hopeless; struggling to recover from these moods; having a pessimistic outlook on the future; feeling a pervasive sense of shame; having a low self-worth; experiencing thoughts of suicide and engaging in suicidal behavior. Evidence: TAS. Frequency: Occasional (HP:0040283). (ORPHA:163921)
- Anxiety (HP:0000739): Intense feelings of nervousness, tension, or panic often arise in response to interpersonal stresses. There is worry about the negative effects of past unpleasant experiences and future negative possibilities. Individuals may feel fearful, apprehensive, or threatened by uncertainty, and they may also have fears of falling apart or losing control. Evidence: TAS. Frequency: Occasional (HP:0040283). (ORPHA:163921)
- Ataxia (HP:0001251): Ataxia refers to impaired coordination of voluntary muscle movement. Cerebellar ataxia refers to ataxia due to dysfunction of the cerebellum. This causes a variety of elementary neurological deficits including asynergy (lack of coordination between muscles, limbs and joints), dysmetria (lack of ability to judge distances that can lead to under- or overshoot in grasping movements), and dysdiadochokinesia (inability to perform rapid movements requiring antagonizing muscle groups to be switched on and off repeatedly). Evidence: TAS. Frequency: Occasional (HP:0040283). (ORPHA:163921)
- Confusion (HP:0001289): Lack of clarity and coherence of thought, perception, understanding, or action. Evidence: TAS. Frequency: Occasional (HP:0040283). (ORPHA:163921)
- Dystonia (HP:0001332): An abnormally increased muscular tone that causes fixed abnormal postures. There is a slow, intermittent twisting motion that leads to exaggerated turning and posture of the extremities and trunk. Evidence: TAS. Frequency: Occasional (HP:0040283). (ORPHA:163921)
- Myoclonus (HP:0001336): Very brief, involuntary random muscular contractions occurring at rest, in response to sensory stimuli, or accompanying voluntary movements. Evidence: TAS. Frequency: Occasional (HP:0040283). (ORPHA:163921)
- EEG with abnormally slow frequencies (HP:0011203): EEG with abnormally slow frequencies. Evidence: TAS. Frequency: Occasional (HP:0040283). (ORPHA:163921)
- Abnormal autonomic nervous system physiology (HP:0012332): A functional abnormality of the autonomic nervous system. Evidence: TAS. Frequency: Occasional (HP:0040283). (ORPHA:163921)
- Abnormal hippocampus morphology (HP:0025100): Any structural anomaly of the hippocampus,. Evidence: TAS. Frequency: Occasional (HP:0040283). (ORPHA:163921)
- Abnormality of movement (HP:0100022): An abnormality of movement with a neurological basis characterized by changes in coordination and speed of voluntary movements. Evidence: TAS. Frequency: Occasional (HP:0040283). (ORPHA:163921)
- Cognitive impairment (HP:0100543): Abnormal cognition is characterized by deficits in thinking, reasoning, or remembering. Evidence: TAS. Frequency: Occasional (HP:0040283). (ORPHA:163921)